Phenotypes associated with the disease jaundice, familial obstructive, of infancy (OMIM:308600, an entry in Online Mendelian Inheritance in Man):
- X-linked recessive inheritance (HP:0001419, a Human Phenotype Ontology term): A mode of inheritance that is observed for recessive traits related to a gene encoded on the X chromosome. In the context of medical genetics, X-linked recessive disorders manifest in males (who have one copy of the X chromosome and are thus hemizygotes), but generally not in female heterozygotes who have one mutant and one normal allele. Evidence: TAS. (OMIM:308600)
- Neonatal hyperbilirubinemia (HP:0003265, a Human Phenotype Ontology term): A type of hyperbilirubinemia with neonatal onset. Evidence: TAS. (OMIM:308600)
- Jaundice (HP:0000952, a Human Phenotype Ontology term): Yellow pigmentation of the skin due to bilirubin, which in turn is the result of increased bilirubin concentration in the bloodstream. Evidence: TAS. (OMIM:308600)